- Craniosynostosis (HP:0001363): Craniosynostosis refers to the premature closure of the cranial sutures. Primary craniosynostosis refers to the closure of one or more sutures due to abnormalities in skull development, and secondary craniosynostosis results from failure of brain growth. Evidence: IEA. (OMIM:241520)
- Sensorineural hearing impairment (HP:0000407): A type of hearing impairment in one or both ears related to an abnormal functionality of the cochlear nerve. Evidence: IEA. (OMIM:241520)
- Increased bone mineral density (HP:0011001): An abnormal increase of bone mineral density, that is, of the amount of matter per cubic centimeter of bones which is often referred to as osteosclerosis. Osteosclerosis can be detected on radiological examination as an increased whiteness (density) of affected bones. Evidence: IEA. (OMIM:241520)
- Rickets (HP:0002748): Rickets is divided into two major categories including calcipenic and phosphopenic. Hypophosphatemia is described as a common manifestation of both categories. Hypophosphatemic rickets is the most common type of rickets that is characterized by low levels of serum phosphate, resistance to ultraviolet radiation or vitamin D intake. There are several issues involved in hypophosphatemic rickets such as calcium, vitamin D, phosphorus deficiencies. Moreover, other disorder can be associated with its occurrence such as absorption defects due to pancreatic, intestinal, gastric, and renal disorders and hepatobiliary disease. Symptoms are usually seen in childhood and can be varied in severity. Severe forms may be linked to bowing of the legs, poor bone growth, and short stature as well as joint and bone pain. Hypophosphatemic rickets are associated with renal excretion of phosphate, hypophosphatemia, and mineral defects in bones. The familial type of the disease is the most common type of rickets. Evidence: IEA. (OMIM:241520)
- Autosomal recessive inheritance (HP:0000007): A mode of inheritance that is observed for traits related to a gene encoded on one of the autosomes (i.e., the human chromosomes 1-22) in which a trait manifests in individuals with two pathogenic alleles, either homozygotes (two copies of the same mutant allele) or compound heterozygotes (whereby each copy of a gene has a distinct mutant allele). Evidence: IEA. (OMIM:241520)
- Hypophosphatemic rickets (HP:0004912). Evidence: TAS. (OMIM:241520)
- Hypophosphatemia (HP:0002148): The concentration of phosphate ion in the blood circulation is below the lower limit of normal. Evidence: IEA. (OMIM:241520)
These phenotypes are associated with the disease hypophosphatemic rickets, autosomal recessive, 1 (OMIM:241520).